- Inguinal hernia (HP:0000023): Protrusion of the contents of the abdominal cavity through the inguinal canal. Evidence: TAS. Frequency: Occasional (HP:0040283). (ORPHA:1292)
- Wide mouth (HP:0000154): Distance between the oral commissures more than 2 SD above the mean. Alternatively, an apparently increased width of the oral aperture (subjective). Evidence: TAS. Frequency: Frequent (HP:0040282). (ORPHA:1292)
- Brachycephaly (HP:0000248): An abnormality of skull shape characterized by a decreased anterior-posterior diameter. That is, a cephalic index greater than 81%. Alternatively, an apparently shortened anteroposterior dimension (length) of the head compared to width. Evidence: TAS. Frequency: Occasional (HP:0040283). (ORPHA:1292)
- Microcephaly (HP:0000252): Head circumference below 2 standard deviations below the mean for age and gender. Evidence: TAS. Frequency: Very frequent (HP:0040281). (ORPHA:1292)
- Malar flattening (HP:0000272): Underdevelopment of the malar prominence of the jugal bone (zygomatic bone in mammals), appreciated in profile, frontal view, and/or by palpation. Evidence: TAS. Frequency: Frequent (HP:0040282). (ORPHA:1292)
- Coarse facial features (HP:0000280): Absence of fine and sharp appearance of brows, nose, lips, mouth, and chin, usually because of rounded and heavy features or thickened skin with or without thickening of subcutaneous and bony tissues. Evidence: TAS. Frequency: Occasional (HP:0040283). (ORPHA:1292)
- Epicanthus (HP:0000286): A fold of skin starting above the medial aspect of the upper eyelid and arching downward to cover, pass in front of and lateral to the medial canthus. Evidence: TAS. Frequency: Frequent (HP:0040282). (ORPHA:1292)
- Pointed chin (HP:0000307): A marked tapering of the lower face to the chin. Evidence: TAS. Frequency: Frequent (HP:0040282). (ORPHA:1292)
- Triangular face (HP:0000325): Facial contour, as viewed from the front, triangular in shape, with breadth at the temples and tapering to a narrow chin. Evidence: TAS. Frequency: Frequent (HP:0040282). (ORPHA:1292)
- Long philtrum (HP:0000343): Distance between nasal base and midline upper lip vermilion border more than 2 SD above the mean. Alternatively, an apparently increased distance between nasal base and midline upper lip vermilion border. Evidence: TAS. Frequency: Very frequent (HP:0040281). (ORPHA:1292)
- High forehead (HP:0000348): An abnormally increased height of the forehead. Evidence: TAS. Frequency: Frequent (HP:0040282). (ORPHA:1292)
- Wide nasal bridge (HP:0000431): Increased breadth of the nasal bridge (and with it, the nasal root). Evidence: TAS. Frequency: Very frequent (HP:0040281). (ORPHA:1292)
- Prominent nose (HP:0000448): Distance between subnasale and pronasale more than two standard deviations above the mean, or alternatively, an apparently increased anterior protrusion of the nasal tip. Evidence: TAS. Frequency: Frequent (HP:0040282). (ORPHA:1292)
- Strabismus (HP:0000486): A misalignment of the eyes so that the visual axes deviate from bifoveal fixation. The classification of strabismus may be based on a number of features including the relative position of the eyes, whether the deviation is latent or manifest, intermittent or constant, concomitant or otherwise and according to the age of onset and the relevance of any associated refractive error. Evidence: TAS. Frequency: Frequent (HP:0040282). (ORPHA:1292)
- Thick eyebrow (HP:0000574): Increased density/number and/or increased diameter of eyebrow hairs. Evidence: TAS. Frequency: Occasional (HP:0040283). (ORPHA:1292)
- Brachydactyly (HP:0001156): Digits that appear disproportionately short compared to the hand/foot. The word brachydactyly is used here to describe a series distinct patterns of shortened digits (brachydactyly types A-E). This is the sense used here. Evidence: TAS. Frequency: Very frequent (HP:0040281). (ORPHA:1292)
- Mild intellectual disability (HP:0001256): Mild intellectual disability (ID) is defined as a type of ID characterized by mildly sub-average adaptive functioning and intellectual functioning, with an intelligence quotient (IQ) the range of 50-69. Evidence: TAS. Frequency: Occasional (HP:0040283). (ORPHA:1292)
- Intrauterine growth retardation (HP:0001511): An abnormal restriction of fetal growth with fetal weight below the tenth percentile for gestational age. Evidence: TAS. Frequency: Frequent (HP:0040282). (ORPHA:1292)
- Umbilical hernia (HP:0001537): Protrusion of abdominal contents through a defect in the abdominal wall musculature around the umbilicus. Skin and subcutaneous tissue overlie the defect. Evidence: TAS. Frequency: Occasional (HP:0040283). (ORPHA:1292)
- Atrial septal defect (HP:0001631): Atrial septal defect (ASD) is a congenital abnormality of the interatrial septum that enables blood flow between the left and right atria via the interatrial septum. Evidence: TAS. Frequency: Occasional (HP:0040283). (ORPHA:1292)
- Abnormal mitral valve morphology (HP:0001633): Any structural anomaly of the mitral valve. Evidence: TAS. Frequency: Occasional (HP:0040283). (ORPHA:1292)
- Hypoplastic toenails (HP:0001800): Underdevelopment of the toenail. Evidence: TAS. Frequency: Very frequent (HP:0040281). (ORPHA:1292)
- Absent toenail (HP:0001802): Congenital absence of the toenail. Evidence: TAS. Frequency: Very frequent (HP:0040281). (ORPHA:1292)
- Hypoplastic fingernail (HP:0001804): Underdevelopment of a fingernail. Evidence: TAS. Frequency: Very frequent (HP:0040281). (ORPHA:1292)
- Absent fingernail (HP:0001817): Absence of a fingernail. Evidence: TAS. Frequency: Very frequent (HP:0040281). (ORPHA:1292)
- Short distal phalanx of toe (HP:0001857): Short distance from the end of the toe to the most distal interphalangeal crease or distal interphalangeal joint flexion point, i.e., abnormally short distal phalanx of toe. Evidence: TAS. Frequency: Very frequent (HP:0040281). (ORPHA:1292)
- Frontal bossing (HP:0002007): Bilateral bulging of the lateral frontal bone prominences with relative sparing of the midline. Evidence: TAS. Frequency: Frequent (HP:0040282). (ORPHA:1292)
- Abnormality of the respiratory system (HP:0002086): An abnormality of the respiratory system, which include the airways, lungs, and the respiratory muscles. Evidence: TAS. Frequency: Occasional (HP:0040283). (ORPHA:1292)
- Generalized hirsutism (HP:0002230): Abnormally increased hair growth over much of the entire body. Evidence: TAS. Frequency: Occasional (HP:0040283). (ORPHA:1292)
- Delayed skeletal maturation (HP:0002750): A decreased rate of skeletal maturation. Delayed skeletal maturation can be diagnosed on the basis of an estimation of the bone age from radiographs of specific bones in the human body. Evidence: TAS. Frequency: Very frequent (HP:0040281). (ORPHA:1292)
- Clinodactyly of the 5th finger (HP:0004209): Clinodactyly refers to a bending or curvature of the fifth finger in the radial direction (i.e., towards the 4th finger). Evidence: TAS. Frequency: Occasional (HP:0040283). (ORPHA:1292)
- Short stature (HP:0004322): A height below that which is expected according to age and gender norms. Although there is no universally accepted definition of short stature, many refer to "short stature" as height more than 2 standard deviations below the mean for age and gender (or below the 3rd percentile for age and gender dependent norms). Evidence: TAS. Frequency: Very frequent (HP:0040281). (ORPHA:1292)
- Biparietal narrowing (HP:0004422): A narrowing of the biparietal diameter (i.e., of the transverse distance between the protuberances of the two parietal bones of the skull). Evidence: TAS. Frequency: Frequent (HP:0040282). (ORPHA:1292)
- Hypoplastic fifth fingernail (HP:0008398): A nail of the fifth finger that is diminished in length and width, i.e., underdeveloped nail of little finger. Evidence: TAS. Frequency: Very frequent (HP:0040281). (ORPHA:1292)
- Finger symphalangism (HP:0009700): An abnormal union between bones or parts of bones of the fingers. The synonymous term "symphalangism of the hand" may be translated as fusions of bones of varying digree, that involve at least one phalangeal bone of the hand. If bony fusions are referred to as "Symphalangism" the fusion occurs in a proximo-distal axis. Fusions of bones of the fingers in a radio-ulnar axis are referred to as "bony" Syndactyly. Evidence: TAS. Frequency: Occasional (HP:0040283). (ORPHA:1292)
- High anterior hairline (HP:0009890): Distance between the hairline (trichion) and the glabella (the most prominent point on the frontal bone above the root of the nose), in the midline, more than two SD above the mean. Alternatively, an apparently increased distance between the hairline and the glabella. Evidence: TAS. Frequency: Occasional (HP:0040283). (ORPHA:1292)
- Toenail dysplasia (HP:0100797): An abnormality of the development of the toenails. Evidence: TAS. Frequency: Very frequent (HP:0040281). (ORPHA:1292)
- Fingernail dysplasia (HP:0100798): An abnormality of the development of the fingernails. Evidence: TAS. Frequency: Very frequent (HP:0040281). (ORPHA:1292)
These phenotypes are associated with the disease Brachymorphism-onychodysplasia-dysphalangism syndrome (ORPHA:1292).